- Abnormality of the eye (HP:0000478): Any abnormality of the eye, including location, spacing, and intraocular abnormalities. Evidence: TAS. Frequency: Occasional (HP:0040283). (ORPHA:71276)
- Deeply set eye (HP:0000490): An eye that is more deeply recessed into the plane of the face than is typical. Evidence: TAS. Frequency: Very frequent (HP:0040281). (ORPHA:71276)
- Abnormality of vision (HP:0000504): Abnormality of eyesight (visual perception). Evidence: TAS. Frequency: Occasional (HP:0040283). (ORPHA:71276)
These phenotypes are associated with the disease Silent sinus syndrome (ORPHA:71276).